Phenotypes associated with the disease intellectual developmental disorder with poor growth and with or without seizures or ataxia (OMIM:618808):
- Incoordination (HP:0002311): A deficit in coordination of muscle movements. Coordination is defined as the orchestrated movement of multiple body parts as required to accomplish intended actions, like walking. Evidence: PCS. Frequency: 2/2. (PMID:31047799)
- Microcephaly (HP:0000252): Head circumference below 2 standard deviations below the mean for age and gender. Evidence: PCS. Frequency: 1/3. (PMID:29302074)
- Mild intellectual disability (HP:0001256): Mild intellectual disability (ID) is defined as a type of ID characterized by mildly sub-average adaptive functioning and intellectual functioning, with an intelligence quotient (IQ) the range of 50-69. Evidence: PCS. Frequency: 1/2. (PMID:31047799)
- Delayed ability to walk (HP:0031936): A failure to achieve the ability to walk at an appropriate developmental stage. Most children learn to walk in a series of stages, and learn to walk short distances independently between 12 and 15 months. Evidence: PCS. Frequency: 2/2. (PMID:31047799)
- Seizure (HP:0001250): A seizure is an intermittent abnormality of nervous system physiology characterized by a transient occurrence of signs and/or symptoms due to abnormal excessive or synchronous neuronal activity in the brain. Evidence: PCS. Frequency: 1/3. (PMID:29302074)
- Fair hair (HP:0002286): A lesser degree of hair pigmentation than would otherwise be expected. Evidence: PCS. Frequency: 2/3. (PMID:29302074)
- Gait ataxia (HP:0002066): A type of ataxia characterized by the impairment of the ability to coordinate the movements required for normal walking. Gait ataxia is characteirzed by a wide-based staggering gait with a tendency to fall. Evidence: IEA. Frequency: 2/2. (PMID:31047799)
- Dysarthria (HP:0001260): Dysarthric speech is a general description referring to a neurological speech disorder characterized by poor articulation. Depending on the involved neurological structures, dysarthria may be further classified as spastic, flaccid, ataxic, hyperkinetic and hypokinetic, or mixed. Evidence: PCS. Frequency: 2/2. (PMID:31047799)
- Elevated circulating LDL-C concentration (HP:0003141): The concentration of low-density lipoprotein cholesterol in the blood circulation is above the upper limit of normal. Evidence: PCS. Frequency: 2/2. (PMID:31047799)
- Mild global developmental delay (HP:0011342): A mild delay in the achievement of motor or mental milestones in the domains of development of a child. Evidence: PCS. Frequency: 3/3. (PMID:29302074)
- Aggressive behavior (HP:0000718): Behavior or an act aimed at harming a person, animal, or physical property (e.g., acts of physical violence; shouting, swearing, and using harsh language; slashing someone's tires). Evidence: PCS. Frequency: 1/2. (PMID:31047799)
- Developmental cataract (HP:0000519): A cataract that occurs congenitally as the result of a developmental defect, in contrast to the majority of cataracts that occur in adulthood as the result of degenerative changes of the lens. Evidence: PCS. Frequency: 1/3. Onset: Congenital onset (HP:0003577). (PMID:29302074)
- Autosomal recessive inheritance (HP:0000007): A mode of inheritance that is observed for traits related to a gene encoded on one of the autosomes (i.e., the human chromosomes 1-22) in which a trait manifests in individuals with two pathogenic alleles, either homozygotes (two copies of the same mutant allele) or compound heterozygotes (whereby each copy of a gene has a distinct mutant allele). Evidence: PCS. (PMID:29302074)
- Muscle weakness (HP:0001324): Reduced strength of muscles. Evidence: PCS. Frequency: 1/3. (PMID:29302074)
- Intellectual disability (HP:0001249): The term intellectual disability or intellectual developmental disorder is used to describe significantly sub-average intellectual and adaptive functioning based on clinical assessment and as measured by individually administered, appropriately normed, standardized and validated tests of intellectual functioning and adaptive behavior, with onset during the developmental period from infancy through adolescence. Evidence: PCS. (PMID:29302074)